- Nuclear cataract (HP:0100018): A nuclear cataract is an opacity or clouding that develops in the lens nucleus. That is, a nuclear cataract is one that is located in the center of the lens. The nucleus tends to darken changing from clear to yellow and sometimes brown. Evidence: PCS. Frequency: 11/11. Onset: Congenital onset (HP:0003577). (PMID:9788845)
- Congenital onset (HP:0003577): A phenotypic abnormality that is present at birth. Evidence: PCS. Frequency: 11/11. (PMID:9788845)
- Posterior Y-sutural cataract (HP:0008031): A type of sutural cataract in which the opacity follows the posterior Y suture. Evidence: TAS. (OMIM:600881)
- Developmental cataract (HP:0000519): A cataract that occurs congenitally as the result of a developmental defect, in contrast to the majority of cataracts that occur in adulthood as the result of degenerative changes of the lens. Evidence: PCS. (PMID:9788845)
- Autosomal dominant inheritance (HP:0000006): A mode of inheritance that is observed for traits related to a gene encoded on one of the autosomes (i.e., the human chromosomes 1-22) in which a trait manifests in heterozygotes. In the context of medical genetics, an autosomal dominant disorder is caused when a single copy of the mutant allele is present. Males and females are affected equally, and can both transmit the disorder with a risk of 50% for each child of inheriting the mutant allele. Evidence: PCS. (PMID:9788845)
- Zonular cataract (HP:0010920): Zonular cataracts are defined to be cataracts that affect specific regions of the lens. Evidence: TAS. (OMIM:600881)
These phenotypes are associated with the disease cataract 10 multiple types (OMIM:600881).